Phenotypes associated with the disease Spastic paraplegia-severe developmental delay-epilepsy syndrome (ORPHA:464282):
- Seizure (HP:0001250): A seizure is an intermittent abnormality of nervous system physiology characterized by a transient occurrence of signs and/or symptoms due to abnormal excessive or synchronous neuronal activity in the brain. Evidence: TAS. Frequency: Very frequent (HP:0040281). (ORPHA:464282)
- Global developmental delay (HP:0001263): A delay in the achievement of motor or mental milestones in the domains of development of a child, including motor skills, speech and language, cognitive skills, and social and emotional skills. This term should only be used to describe children younger than five years of age. Evidence: TAS. Frequency: Very frequent (HP:0040281). (ORPHA:464282)
- Progressive spastic paraplegia (HP:0007020). Evidence: TAS. Frequency: Very frequent (HP:0040281). (ORPHA:464282)
- Hypertelorism (HP:0000316): Interpupillary distance more than 2 SD above the mean (alternatively, the appearance of an increased interpupillary distance or widely spaced eyes). Evidence: TAS. Frequency: Frequent (HP:0040282). (ORPHA:464282)
- Sensorineural hearing impairment (HP:0000407): A type of hearing impairment in one or both ears related to an abnormal functionality of the cochlear nerve. Evidence: TAS. Frequency: Frequent (HP:0040282). (ORPHA:464282)
- Deeply set eye (HP:0000490): An eye that is more deeply recessed into the plane of the face than is typical. Evidence: TAS. Frequency: Frequent (HP:0040282). (ORPHA:464282)
- Myopia (HP:0000545): An abnormality of refraction characterized by the ability to see objects nearby clearly, while objects in the distance appear blurry. Evidence: TAS. Frequency: Frequent (HP:0040282). (ORPHA:464282)
- Retinal dystrophy (HP:0000556): Retinal dystrophy is an abnormality of the retina associated with a hereditary process. Retinal dystrophies are defined by their predominantly monogenic inheritance and they are frequently associated with loss or dysfunction of photoreceptor cells as a primary or secondary event. Evidence: TAS. Frequency: Frequent (HP:0040282). (ORPHA:464282)
- Delayed speech and language development (HP:0000750): A degree of language development that is significantly below the norm for a child of a specified age. Evidence: TAS. Frequency: Frequent (HP:0040282). (ORPHA:464282)
- Intellectual disability (HP:0001249): The term intellectual disability or intellectual developmental disorder is used to describe significantly sub-average intellectual and adaptive functioning based on clinical assessment and as measured by individually administered, appropriately normed, standardized and validated tests of intellectual functioning and adaptive behavior, with onset during the developmental period from infancy through adolescence. Evidence: TAS. Frequency: Frequent (HP:0040282). (ORPHA:464282)
- Ataxia (HP:0001251): Ataxia refers to impaired coordination of voluntary muscle movement. Cerebellar ataxia refers to ataxia due to dysfunction of the cerebellum. This causes a variety of elementary neurological deficits including asynergy (lack of coordination between muscles, limbs and joints), dysmetria (lack of ability to judge distances that can lead to under- or overshoot in grasping movements), and dysdiadochokinesia (inability to perform rapid movements requiring antagonizing muscle groups to be switched on and off repeatedly). Evidence: TAS. Frequency: Frequent (HP:0040282). (ORPHA:464282)
- Spasticity (HP:0001257): A motor disorder characterized by a velocity-dependent increase in tonic stretch reflexes with increased muscle tone, exaggerated (hyperexcitable) tendon reflexes. Evidence: TAS. Frequency: Frequent (HP:0040282). (ORPHA:464282)
- Dysarthria (HP:0001260): Dysarthric speech is a general description referring to a neurological speech disorder characterized by poor articulation. Depending on the involved neurological structures, dysarthria may be further classified as spastic, flaccid, ataxic, hyperkinetic and hypokinetic, or mixed. Evidence: TAS. Frequency: Frequent (HP:0040282). (ORPHA:464282)
- Gait disturbance (HP:0001288): The term gait disturbance can refer to any disruption of the ability to walk. Evidence: TAS. Frequency: Frequent (HP:0040282). (ORPHA:464282)
- Dystonia (HP:0001332): An abnormally increased muscular tone that causes fixed abnormal postures. There is a slow, intermittent twisting motion that leads to exaggerated turning and posture of the extremities and trunk. Evidence: TAS. Frequency: Frequent (HP:0040282). (ORPHA:464282)
- Lower limb spasticity (HP:0002061): Spasticity (velocity-dependent increase in tonic stretch reflexes with increased muscle tone and hyperexcitable tendon reflexes) in the muscles of the lower limbs, hips, and pelvis. Evidence: TAS. Frequency: Frequent (HP:0040282). (ORPHA:464282)
- Generalized myoclonic seizure (HP:0002123): A generalized myoclonic seizure is a type of generalized motor seizure characterized by bilateral, sudden, brief (<100 ms) involuntary single or multiple contraction of muscles or muscle groups of variable topography (axial, proximal limb, distal). Myoclonus is less regularly repetitive and less sustained than is clonus. Evidence: TAS. Frequency: Frequent (HP:0040282). (ORPHA:464282)
- Unsteady gait (HP:0002317). Evidence: TAS. Frequency: Frequent (HP:0040282). (ORPHA:464282)
- Waddling gait (HP:0002515): Weakness of the hip girdle and upper thigh muscles, for instance in myopathies, leads to an instability of the pelvis on standing and walking. If the muscles extending the hip joint are affected, the posture in that joint becomes flexed and lumbar lordosis increases. The patients usually have difficulties standing up from a sitting position. Due to weakness in the gluteus medius muscle, the hip on the side of the swinging leg drops with each step (referred to as Trendelenburg sign). The gait appears waddling. The patients frequently attempt to counteract the dropping of the hip on the swinging side by bending the trunk towards the side which is in the stance phase (in the German language literature this is referred to as Duchenne sign). Similar gait patterns can be caused by orthopedic conditions when the origin and the insertion site of the gluteus medius muscle are closer to each other than normal, for instance due to a posttraumatic elevation of the trochanter or pseudarthrosis of the femoral neck. Evidence: TAS. Frequency: Frequent (HP:0040282). (ORPHA:464282)
- Scoliosis (HP:0002650): The presence of an abnormal lateral curvature of the spine. Evidence: TAS. Frequency: Frequent (HP:0040282). (ORPHA:464282)
- Downturned corners of mouth (HP:0002714): A morphological abnormality of the mouth in which the angle of the mouth is downturned. The oral commissures are positioned inferior to the midline labial fissure. Evidence: TAS. Frequency: Frequent (HP:0040282). (ORPHA:464282)
- Kyphosis (HP:0002808): Exaggerated anterior convexity of the thoracic vertebral column. Evidence: TAS. Frequency: Frequent (HP:0040282). (ORPHA:464282)
- Hip dislocation (HP:0002827): Displacement of the femur from its normal location in the hip joint. Evidence: TAS. Frequency: Frequent (HP:0040282). (ORPHA:464282)
- Axial hypotonia (HP:0008936): Muscular hypotonia (abnormally low muscle tone) affecting the musculature of the trunk. Evidence: TAS. Frequency: Frequent (HP:0040282). (ORPHA:464282)
- Exophoria (HP:0025313): A form of strabismus with one or both eyes deviated outward to a milder degree than with exotropia. Evidence: TAS. Frequency: Frequent (HP:0040282). (ORPHA:464282)
- Absent pubertal growth spurt (HP:0031087): The abrupt and transient increase in the annual growth rate normally observed in adolescent individuals does not occur. Evidence: TAS. Frequency: Frequent (HP:0040282). (ORPHA:464282)
- Urinary incontinence (HP:0000020): Loss of the ability to control the urinary bladder leading to involuntary urination. Evidence: TAS. Frequency: Occasional (HP:0040283). (ORPHA:464282)
- Microcephaly (HP:0000252): Head circumference below 2 standard deviations below the mean for age and gender. Evidence: TAS. Frequency: Occasional (HP:0040283). (ORPHA:464282)
- Obesity (HP:0001513): Accumulation of substantial excess body fat. Evidence: TAS. Frequency: Occasional (HP:0040283). (ORPHA:464282)
- Cerebral atrophy (HP:0002059): Atrophy (wasting, decrease in size of cells or tissue) affecting the cerebrum. Evidence: TAS. Frequency: Occasional (HP:0040283). (ORPHA:464282)
- Bilateral tonic-clonic seizure (HP:0002069): A bilateral tonic-clonic seizure is a seizure defined by a tonic (bilateral increased tone, lasting seconds to minutes) and then a clonic (bilateral sustained rhythmic jerking) phase. Evidence: TAS. Frequency: Occasional (HP:0040283). (ORPHA:464282)
- Hypoplasia of the corpus callosum (HP:0002079): Underdevelopment of the corpus callosum. Evidence: TAS. Frequency: Occasional (HP:0040283). (ORPHA:464282)
- Short stature (HP:0004322): A height below that which is expected according to age and gender norms. Although there is no universally accepted definition of short stature, many refer to "short stature" as height more than 2 standard deviations below the mean for age and gender (or below the 3rd percentile for age and gender dependent norms). Evidence: TAS. Frequency: Occasional (HP:0040283). (ORPHA:464282)
- Puberty and gonadal disorders (HP:0008373). Evidence: TAS. Frequency: Occasional (HP:0040283). (ORPHA:464282)
- Structural foot deformity (HP:0010219): A foot deformity resulting due to an abnormality affecting the bones of the foot (as well as muscle and soft tissue). In contrast if only the muscle and soft tissue are affected the term positional foot deformity applies. Evidence: TAS. Frequency: Occasional (HP:0040283). (ORPHA:464282)
- Focal myoclonic seizure (HP:0011166): A type of focal motor seizure characterized by sudden, brief (<100 ms) involuntary single or multiple contraction(s) of muscles(s) or muscle groups of variable topography (axial, proximal limb, distal). Myoclonus is less regularly repetitive and less sustained than is clonus. Evidence: TAS. Frequency: Occasional (HP:0040283). (ORPHA:464282)
- Delayed peripheral myelination (HP:0011401): Delayed myelination in the peripheral nervous system. Evidence: TAS. Frequency: Occasional (HP:0040283). (ORPHA:464282)
- Cerebral white matter atrophy (HP:0012762): The presence of atrophy (wasting) of the cerebral white matter. Evidence: TAS. Frequency: Occasional (HP:0040283). (ORPHA:464282)
Not associated with this disease:
- Abnormality of the musculature of the lower limbs (HP:0001437). Evidence: TAS. (ORPHA:464282)
- Fasciculations (HP:0002380): Fasciculations are observed as small, local, involuntary muscle contractions (twitching) visible under the skin. Fasciculations result from increased irritability of an axon (which in turn is often a manifestation of disease of a motor neuron). This leads to sporadic discharges of all the muscle fibers controlled by the axon in isolation from other motor units. Evidence: TAS. (ORPHA:464282)